Phenotypes associated with the disease melanoma, cutaneous malignant, susceptibility to, 9 (OMIM:615134):
- Melanoma (HP:0002861): The presence of a melanoma, a malignant cancer originating from pigment producing melanocytes. Melanoma can originate from the skin or the pigmented layers of the eye (the uvea). Evidence: PCS. (PMID:23348503)
- Autosomal dominant inheritance (HP:0000006): A mode of inheritance that is observed for traits related to a gene encoded on one of the autosomes (i.e., the human chromosomes 1-22) in which a trait manifests in heterozygotes. In the context of medical genetics, an autosomal dominant disorder is caused when a single copy of the mutant allele is present. Males and females are affected equally, and can both transmit the disorder with a risk of 50% for each child of inheriting the mutant allele. Evidence: PCS. (PMID:23348503)